- Thick lower lip vermilion (HP:0000179): Increased thickness of the lower lip, leading to a prominent appearance of the lower lip. The height of the vermilion of the lower lip in the midline is more than 2 SD above the mean. Alternatively, an apparently increased height of the vermilion of the lower lip in the frontal view (subjective). Evidence: TAS. Frequency: Very frequent (HP:0040281). (ORPHA:2135)
- High palate (HP:0000218): Height of the palate more than 2 SD above the mean (objective) or palatal height at the level of the first permanent molar more than twice the height of the teeth (subjective). Evidence: TAS. Frequency: Very frequent (HP:0040281). (ORPHA:2135)
- Triangular face (HP:0000325): Facial contour, as viewed from the front, triangular in shape, with breadth at the temples and tapering to a narrow chin. Evidence: TAS. Frequency: Very frequent (HP:0040281). (ORPHA:2135)
- Optic atrophy (HP:0000648): Atrophy of the optic nerve. Optic atrophy results from the death of the retinal ganglion cell axons that comprise the optic nerve and manifesting as a pale optic nerve on fundoscopy. Evidence: TAS. Frequency: Very frequent (HP:0040281). (ORPHA:2135)
- Pruritus (HP:0000989): Pruritus is an itch or a sensation that makes a person want to scratch. This term refers to an abnormally increased disposition to experience pruritus. Evidence: TAS. Frequency: Very frequent (HP:0040281). (ORPHA:2135)
- Abnormal skin pigmentation (HP:0001000): An abnormality of the pigmentation of the skin. Evidence: TAS. Frequency: Very frequent (HP:0040281). (ORPHA:2135)
- Intellectual disability (HP:0001249): The term intellectual disability or intellectual developmental disorder is used to describe significantly sub-average intellectual and adaptive functioning based on clinical assessment and as measured by individually administered, appropriately normed, standardized and validated tests of intellectual functioning and adaptive behavior, with onset during the developmental period from infancy through adolescence. Evidence: TAS. Frequency: Occasional (HP:0040283). (ORPHA:2135)
- Hypotonia (HP:0001252): Hypotonia is an abnormally low muscle tone (the amount of tension or resistance to movement in a muscle). Even when relaxed, muscles have a continuous and passive partial contraction which provides some resistance to passive stretching. Hypotonia thus manifests as diminished resistance to passive stretching. Hypotonia is not the same as muscle weakness, although the two conditions can co-exist. Evidence: TAS. Frequency: Very frequent (HP:0040281). (ORPHA:2135)
- Areflexia (HP:0001284): Absence of neurologic reflexes such as the knee-jerk reaction. Evidence: TAS. Frequency: Very frequent (HP:0040281). (ORPHA:2135)
- Failure to thrive (HP:0001508): Failure to thrive (FTT) refers to a child whose physical growth is substantially below the norm. Evidence: TAS. Frequency: Very frequent (HP:0040281). (ORPHA:2135)
- Pneumonia (HP:0002090): Inflammation of any part of the lung parenchyma. Evidence: TAS. Frequency: Occasional (HP:0040283). (ORPHA:2135)
- Respiratory insufficiency (HP:0002093). Evidence: TAS. Frequency: Occasional (HP:0040283). (ORPHA:2135)
- Ventriculomegaly (HP:0002119): An increase in size of the ventricular system of the brain. Evidence: TAS. Frequency: Very frequent (HP:0040281). (ORPHA:2135)
- Hypotension (HP:0002615): Low Blood Pressure, vascular hypotension. Evidence: TAS. Frequency: Occasional (HP:0040283). (ORPHA:2135)
- Scoliosis (HP:0002650): The presence of an abnormal lateral curvature of the spine. Evidence: TAS. Frequency: Occasional (HP:0040283). (ORPHA:2135)
- Short stature (HP:0004322): A height below that which is expected according to age and gender norms. Although there is no universally accepted definition of short stature, many refer to "short stature" as height more than 2 standard deviations below the mean for age and gender (or below the 3rd percentile for age and gender dependent norms). Evidence: TAS. Frequency: Very frequent (HP:0040281). (ORPHA:2135)
- Microtia (HP:0008551): Underdevelopment of the external ear. Evidence: TAS. Frequency: Very frequent (HP:0040281). (ORPHA:2135)
- Severe global developmental delay (HP:0011344): A severe delay in the achievement of motor or mental milestones in the domains of development of a child. Evidence: TAS. Frequency: Occasional (HP:0040283). (ORPHA:2135)
- Fatigue (HP:0012378): A subjective feeling of tiredness characterized by a lack of energy and motivation. Evidence: TAS. Frequency: Occasional (HP:0040283). (ORPHA:2135)
- Lower limb asymmetry (HP:0100559): A difference in length or diameter between the left and right leg. Evidence: TAS. Frequency: Occasional (HP:0040283). (ORPHA:2135)
- Papule (HP:0200034): A circumscribed, solid elevation of skin with no visible fluid, varying in size from a pinhead to less than 10mm in diameter at the widest point. Evidence: TAS. Frequency: Very frequent (HP:0040281). (ORPHA:2135)
- Microcephaly (HP:0000252): Head circumference below 2 standard deviations below the mean for age and gender. Evidence: TAS. Frequency: Very frequent (HP:0040281). (ORPHA:2135)
- Delayed cranial suture closure (HP:0000270): Infants normally have two fontanels at birth, the diamond-shaped anterior fontanelle at the junction of the coronal and sagittal sutures, and the posterior fontanelle at the intersection of the occipital and parietal bones. The posterior fontanelle usually closes by the 8th week of life, and the anterior fontanel closes by the 18th month of life on average. This term applies if there is delay of closure of the fontanelles beyond the normal age. Evidence: TAS. Frequency: Very frequent (HP:0040281). (ORPHA:2135)
- Prominent supraorbital ridges (HP:0000336): Greater than average forward and/or lateral protrusion of the supraorbital portion of the frontal bones. Evidence: TAS. Frequency: Occasional (HP:0040283). (ORPHA:2135)
- Micrognathia (HP:0000347): Developmental hypoplasia of the mandible. Evidence: TAS. Frequency: Very frequent (HP:0040281). (ORPHA:2135)
- Hearing impairment (HP:0000365): A decreased magnitude of the sensory perception of sound. Evidence: TAS. Frequency: Very frequent (HP:0040281). (ORPHA:2135)
- Conductive hearing impairment (HP:0000405): An abnormality of vibrational conductance of sound to the inner ear leading to impairment of sensory perception of sound. Evidence: TAS. Frequency: Very frequent (HP:0040281). (ORPHA:2135)
- Wide nasal bridge (HP:0000431): Increased breadth of the nasal bridge (and with it, the nasal root). Evidence: TAS. Frequency: Occasional (HP:0040283). (ORPHA:2135)
- Wide nose (HP:0000445): Interalar distance more than two standard deviations above the mean for age, i.e., an apparently increased width of the nasal base and alae. Evidence: TAS. Frequency: Occasional (HP:0040283). (ORPHA:2135)
- Proptosis (HP:0000520): An eye that is protruding anterior to the plane of the face to a greater extent than is typical. Evidence: TAS. Frequency: Very frequent (HP:0040281). (ORPHA:2135)
- Upslanted palpebral fissure (HP:0000582): The palpebral fissure inclination is more than two standard deviations above the mean for age (objective); or, the inclination of the palpebral fissure is greater than typical for age. Evidence: TAS. Frequency: Very frequent (HP:0040281). (ORPHA:2135)
- Irritability (HP:0000737): An emotional state characterized by negative feelings of heightened frustration, annoyance, or feeling upset, often triggered by internal factors (e.g., fatigue, hunger, unfulfilled desires) or external factors (e.g., social or environmental challenges). Irritability may be unpredictable, and is accompanied by a lowered threshold for emotional reactivity and observable features (speech, facial expressions, or psychomotor activity). Evidence: TAS. Frequency: Occasional (HP:0040283). (ORPHA:2135)
- Abnormality of the skeletal system (HP:0000924): An abnormality of the skeletal system. Evidence: TAS. Frequency: Occasional (HP:0040283). (ORPHA:2135)
- Urticaria (HP:0001025): Raised, well-circumscribed areas of erythema and edema involving the dermis and epidermis. Urticaria is intensely pruritic, and blanches completely with pressure. Evidence: TAS. Frequency: Very frequent (HP:0040281). (ORPHA:2135)
- Thickened skin (HP:0001072): Laminar thickening of skin. Evidence: TAS. Frequency: Occasional (HP:0040283). (ORPHA:2135)
- Seizure (HP:0001250): A seizure is an intermittent abnormality of nervous system physiology characterized by a transient occurrence of signs and/or symptoms due to abnormal excessive or synchronous neuronal activity in the brain. Evidence: TAS. Frequency: Very frequent (HP:0040281). (ORPHA:2135)
- Subcutaneous nodule (HP:0001482): Slightly elevated lesions on or in the skin with a diameter of over 5 mm. Evidence: TAS. Frequency: Very frequent (HP:0040281). (ORPHA:2135)
- Vomiting (HP:0002013): Forceful ejection of the contents of the stomach through the mouth by means of a series of involuntary spasmic contractions. Evidence: TAS. Frequency: Occasional (HP:0040283). (ORPHA:2135)
- Abdominal pain (HP:0002027): An unpleasant sensation characterized by physical discomfort (such as pricking, throbbing, or aching) and perceived to originate in the abdomen. Evidence: TAS. Frequency: Very frequent (HP:0040281). (ORPHA:2135)
- Long nose (HP:0003189): Distance from nasion to subnasale more than two standard deviations above the mean, or alternatively, an apparently increased length from the nasal root to the nasal base. Evidence: TAS. Frequency: Occasional (HP:0040283). (ORPHA:2135)
- Clinodactyly of the 5th finger (HP:0004209): Clinodactyly refers to a bending or curvature of the fifth finger in the radial direction (i.e., towards the 4th finger). Evidence: TAS. Frequency: Very frequent (HP:0040281). (ORPHA:2135)
- Irregular hyperpigmentation (HP:0007400). Evidence: TAS. Frequency: Very frequent (HP:0040281). (ORPHA:2135)
- Generalized hyperpigmentation (HP:0007440). Evidence: TAS. Frequency: Very frequent (HP:0040281). (ORPHA:2135)
- Erythema (HP:0010783): Redness of the skin, caused by hyperemia of the capillaries in the lower layers of the skin. Evidence: TAS. Frequency: Very frequent (HP:0040281). (ORPHA:2135)
- Arrhythmia (HP:0011675): Any cardiac rhythm other than the normal sinus rhythm. Such a rhythm may be either of sinus or ectopic origin and either regular or irregular. An arrhythmia may be due to a disturbance in impulse formation or conduction or both. Evidence: TAS. Frequency: Occasional (HP:0040283). (ORPHA:2135)
- Macule (HP:0012733): A flat, distinct, discolored area of skin less than 1 cm wide that does not involve any change in the thickness or texture of the skin. Evidence: TAS. Frequency: Very frequent (HP:0040281). (ORPHA:2135)
- Immunologic hypersensitivity (HP:0100326): Immunological states where the immune system produces harmful responses upon reexposure to sensitizing antigens. Evidence: TAS. Frequency: Occasional (HP:0040283). (ORPHA:2135)
- Camptodactyly of finger (HP:0100490): The distal interphalangeal joint and/or the proximal interphalangeal joint of the fingers cannot be extended to 180 degrees by either active or passive extension. Evidence: TAS. Frequency: Very frequent (HP:0040281). (ORPHA:2135)
- Mastocytosis (HP:0100495): The presence of an increased number of mast cells and CD34+ mast cell precursors in the body. Evidence: TAS. Frequency: Very frequent (HP:0040281). (ORPHA:2135)
- Telangiectasia of the skin (HP:0100585): Presence of small, permanently dilated blood vessels near the surface of the skin, visible as small focal red lesions. Evidence: TAS. Frequency: Occasional (HP:0040283). (ORPHA:2135)
- Lichenification (HP:0100725): Thickening and hardening of the epidermis seen with exaggeration of normal skin lines. Evidence: TAS. Frequency: Occasional (HP:0040283). (ORPHA:2135)
- Skin vesicle (HP:0200037): A circumscribed, fluid-containing, epidermal elevation less than 10mm in diameter at the widest point that (i) Contain serous exudates or serum mixed with blood or pus; (ii) Are discrete, grouped, irregularly distributed, or linear as in Rhus dermatitis; (iii) Are short-lived. Vesicles may break spontaneously or evolve into bullae by enlarging or coalescing with other vesicles. Evidence: TAS. Frequency: Occasional (HP:0040283). (ORPHA:2135)
These phenotypes are associated with the disease Cutaneous mastocytosis-deafness-microtia syndrome (ORPHA:2135).